Phenotypes associated with the disease phenformin 4-hydroxylation (OMIM:261590):
- Autosomal recessive inheritance (HP:0000007): A mode of inheritance that is observed for traits related to a gene encoded on one of the autosomes (i.e., the human chromosomes 1-22) in which a trait manifests in individuals with two pathogenic alleles, either homozygotes (two copies of the same mutant allele) or compound heterozygotes (whereby each copy of a gene has a distinct mutant allele). Evidence: IEA. (OMIM:261590)
- Lactic acidosis (HP:0003128): An abnormal buildup of lactic acid in the body, leading to acidification of the blood and other bodily fluids. Evidence: IEA. (OMIM:261590)